- Macroorchidism (HP:0000053): The presence of abnormally large testes. Evidence: TAS. Frequency: Very frequent (HP:0040281). (ORPHA:85286)
- Everted lower lip vermilion (HP:0000232): An abnormal configuration of the lower lip such that it is turned outward i.e., everted, with the Inner aspect of the lower lip vermilion (normally opposing the teeth) being visible in a frontal view. Evidence: TAS. Frequency: Very frequent (HP:0040281). (ORPHA:85286)
- Coarse facial features (HP:0000280): Absence of fine and sharp appearance of brows, nose, lips, mouth, and chin, usually because of rounded and heavy features or thickened skin with or without thickening of subcutaneous and bony tissues. Evidence: TAS. Frequency: Very frequent (HP:0040281). (ORPHA:85286)
- Prominent supraorbital ridges (HP:0000336): Greater than average forward and/or lateral protrusion of the supraorbital portion of the frontal bones. Evidence: TAS. Frequency: Very frequent (HP:0040281). (ORPHA:85286)
- Macrotia (HP:0000400): Median longitudinal ear length greater than two standard deviations above the mean and median ear width greater than two standard deviations above the mean (objective); or, apparent increase in length and width of the pinna (subjective). Evidence: TAS. Frequency: Very frequent (HP:0040281). (ORPHA:85286)
- Bulbous nose (HP:0000414): Increased volume and globular shape of the anteroinferior aspect of the nose. Evidence: TAS. Frequency: Very frequent (HP:0040281). (ORPHA:85286)
- Blepharophimosis (HP:0000581): A fixed reduction in the vertical distance between the upper and lower eyelids with short palpebral fissures. Evidence: TAS. Frequency: Very frequent (HP:0040281). (ORPHA:85286)
- Delayed speech and language development (HP:0000750): A degree of language development that is significantly below the norm for a child of a specified age. Evidence: TAS. Frequency: Very frequent (HP:0040281). (ORPHA:85286)
- Seizure (HP:0001250): A seizure is an intermittent abnormality of nervous system physiology characterized by a transient occurrence of signs and/or symptoms due to abnormal excessive or synchronous neuronal activity in the brain. Evidence: TAS. Frequency: Occasional (HP:0040283). (ORPHA:85286)
- Obesity (HP:0001513): Accumulation of substantial excess body fat. Evidence: TAS. Frequency: Very frequent (HP:0040281). (ORPHA:85286)
- Moderate intellectual disability (HP:0002342): Moderate intellectual disability (ID) is defined as a type of ID characterized by moderately sub-average adaptive functioning and intellectual functioning, with an intelligence quotient (IQ) the range of 35-49. Evidence: TAS. Frequency: Very frequent (HP:0040281). (ORPHA:85286)
- Palpebral edema (HP:0100540): Edema in the region of the eyelids. Evidence: TAS. Frequency: Very frequent (HP:0040281). (ORPHA:85286)
These phenotypes are associated with the disease X-linked intellectual disability, Shashi type (ORPHA:85286).